- Band-shaped corneal dystrophy (HP:0007709): A type of genetically determined disease of the cornea with corneal lesions with a band-like shape. Evidence: IEA. (OMIM:217500)
- Autosomal recessive inheritance (HP:0000007): A mode of inheritance that is observed for traits related to a gene encoded on one of the autosomes (i.e., the human chromosomes 1-22) in which a trait manifests in individuals with two pathogenic alleles, either homozygotes (two copies of the same mutant allele) or compound heterozygotes (whereby each copy of a gene has a distinct mutant allele). Evidence: IEA. (OMIM:217500)
These phenotypes are associated with the disease band keratopathy (OMIM:217500).